- Visual impairment (HP:0000505): Visual impairment (or vision impairment) is vision loss (of a person) to such a degree as to qualify as an additional support need through a significant limitation of visual capability resulting from either disease, trauma, or congenital or degenerative conditions that cannot be corrected by conventional means, such as refractive correction, medication, or surgery. Evidence: TAS. Frequency: Very frequent (HP:0040281). (ORPHA:75374)
- Photophobia (HP:0000613): Excessive sensitivity to light with the sensation of discomfort or pain in the eyes due to exposure to bright light. Evidence: TAS. Frequency: Very frequent (HP:0040281). (ORPHA:75374)
These phenotypes are associated with the disease Bradyopsia (ORPHA:75374).